- Wide mouth (HP:0000154): Distance between the oral commissures more than 2 SD above the mean. Alternatively, an apparently increased width of the oral aperture (subjective). Evidence: TAS. Frequency: Very frequent (HP:0040281). (ORPHA:3051)
- Everted lower lip vermilion (HP:0000232): An abnormal configuration of the lower lip such that it is turned outward i.e., everted, with the Inner aspect of the lower lip vermilion (normally opposing the teeth) being visible in a frontal view. Evidence: TAS. Frequency: Very frequent (HP:0040281). (ORPHA:3051)
- Thin vermilion border (HP:0000233): Height of the vermilion of the medial part of the lip more than 2 SD below the mean, or apparently reduced height of the vermilion of the lip in the frontal view. The vermilion is the red part of the lips (and confusingly, the vermilion itself is also often referred to as being equivalent the lips). Evidence: TAS. Frequency: Very frequent (HP:0040281). (ORPHA:3051)
- Microcephaly (HP:0000252): Head circumference below 2 standard deviations below the mean for age and gender. Evidence: TAS. Frequency: Very frequent (HP:0040281). (ORPHA:3051)
- Smooth philtrum (HP:0000319): Flat skin surface, with no ridge formation in the central region of the upper lip between the nasal base and upper vermilion border. Evidence: TAS. Frequency: Very frequent (HP:0040281). (ORPHA:3051)
- Triangular face (HP:0000325): Facial contour, as viewed from the front, triangular in shape, with breadth at the temples and tapering to a narrow chin. Evidence: TAS. Frequency: Very frequent (HP:0040281). (ORPHA:3051)
- Long philtrum (HP:0000343): Distance between nasal base and midline upper lip vermilion border more than 2 SD above the mean. Alternatively, an apparently increased distance between nasal base and midline upper lip vermilion border. Evidence: TAS. Frequency: Very frequent (HP:0040281). (ORPHA:3051)
- Anteverted nares (HP:0000463): Anteriorly-facing nostrils viewed with the head in the Frankfurt horizontal and the eyes of the observer level with the eyes of the subject. This gives the appearance of an upturned nose (upturned nasal tip). Evidence: TAS. Frequency: Very frequent (HP:0040281). (ORPHA:3051)
- Brachydactyly (HP:0001156): Digits that appear disproportionately short compared to the hand/foot. The word brachydactyly is used here to describe a series distinct patterns of shortened digits (brachydactyly types A-E). This is the sense used here. Evidence: TAS. Frequency: Very frequent (HP:0040281). (ORPHA:3051)
- Intellectual disability (HP:0001249): The term intellectual disability or intellectual developmental disorder is used to describe significantly sub-average intellectual and adaptive functioning based on clinical assessment and as measured by individually administered, appropriately normed, standardized and validated tests of intellectual functioning and adaptive behavior, with onset during the developmental period from infancy through adolescence. Evidence: TAS. Frequency: Very frequent (HP:0040281). (ORPHA:3051)
- Global developmental delay (HP:0001263): A delay in the achievement of motor or mental milestones in the domains of development of a child, including motor skills, speech and language, cognitive skills, and social and emotional skills. This term should only be used to describe children younger than five years of age. Evidence: TAS. Frequency: Very frequent (HP:0040281). (ORPHA:3051)
- Specific learning disability (HP:0001328): Impairment of certain skills such as reading or writing, coordination, self-control, or attention that interfere with the ability to learn. The impairment is not related to a global deficiency of intelligence. Evidence: TAS. Frequency: Very frequent (HP:0040281). (ORPHA:3051)
- Joint dislocation (HP:0001373): Displacement or malalignment of joints. Evidence: TAS. Frequency: Very frequent (HP:0040281). (ORPHA:3051)
- Alopecia (HP:0001596): A noncongenital process of hair loss, which may progress to partial or complete baldness. Evidence: TAS. Frequency: Very frequent (HP:0040281). (ORPHA:3051)
- Mutism (HP:0002300): Complete lack of speech or verbal communication in a person despite attempts to engage in conversation. Mutism as a phenomena assumes the individual has previous capacity for speech and in the pediatric population it assumes that the person is past the age of typical language development. Evidence: TAS. Frequency: Very frequent (HP:0040281). (ORPHA:3051)
- Aphasia (HP:0002381): An acquired language impairment of some or all of the abilities to produce or comprehend speech and to read or write. Evidence: TAS. Frequency: Very frequent (HP:0040281). (ORPHA:3051)
- High, narrow palate (HP:0002705): The presence of a high and narrow palate. Evidence: TAS. Frequency: Very frequent (HP:0040281). (ORPHA:3051)
- Short palm (HP:0004279): Short palm. Evidence: TAS. Frequency: Very frequent (HP:0040281). (ORPHA:3051)
- Sparse hair (HP:0008070): Reduced density of hairs. Evidence: TAS. Frequency: Very frequent (HP:0040281). (ORPHA:3051)
- Thick nasal alae (HP:0009928): Increase in bulk of the ala nasi. Evidence: TAS. Frequency: Very frequent (HP:0040281). (ORPHA:3051)
- Echolalia (HP:0010529): Echolalia is the automatic imitative repetition of sounds, words, or phrases in the absence of explicit awareness. The repeated words or phrases are typically odd or used in a non-social manner. These can be words or phrases that the affected individual has heard or invented. Evidence: TAS. Frequency: Very frequent (HP:0040281). (ORPHA:3051)
- Cryptorchidism (HP:0000028): Testis in inguinal canal. That is, absence of one or both testes from the scrotum owing to failure of the testis or testes to descend through the inguinal canal to the scrotum. Evidence: TAS. Frequency: Frequent (HP:0040282). (ORPHA:3051)
- Abnormal testis morphology (HP:0000035): An anomaly of the testicle (the male gonad). Evidence: TAS. Frequency: Frequent (HP:0040282). (ORPHA:3051)
- Narrow nasal bridge (HP:0000446): Decreased width of the bony bridge of the nose. Evidence: TAS. Frequency: Frequent (HP:0040282). (ORPHA:3051)
- Long eyelashes (HP:0000527): Mid upper eyelash length >10 mm or increased length of the eyelashes (subjective). Evidence: TAS. Frequency: Frequent (HP:0040282). (ORPHA:3051)
- Blepharophimosis (HP:0000581): A fixed reduction in the vertical distance between the upper and lower eyelids with short palpebral fissures. Evidence: TAS. Frequency: Frequent (HP:0040282). (ORPHA:3051)
- Eczematoid dermatitis (HP:0000964): Eczema is a form of dermatitis that is characterized by scaly, pruritic, erythematous lesions located on flexural surfaces. Evidence: TAS. Frequency: Frequent (HP:0040282). (ORPHA:3051)
- Abnormal finger morphology (HP:0001167): An anomaly of a finger. Evidence: TAS. Frequency: Frequent (HP:0040282). (ORPHA:3051)
- Seizure (HP:0001250): A seizure is an intermittent abnormality of nervous system physiology characterized by a transient occurrence of signs and/or symptoms due to abnormal excessive or synchronous neuronal activity in the brain. Evidence: TAS. Frequency: Frequent (HP:0040282). (ORPHA:3051)
- Sandal gap (HP:0001852): A widely spaced gap between the first toe (the great toe) and the second toe. Evidence: TAS. Frequency: Frequent (HP:0040282). (ORPHA:3051)
- Generalized non-motor (absence) seizure (HP:0002121): A generalized non-motor (absence) seizure is a type of a type of dialeptic seizure that is of electrographically generalized onset. It is a generalized seizure characterized by an interruption of activities, a blank stare, and usually the person will be unresponsive when spoken to. Any ictal motor phenomena are minor in comparison to these non-motor features. Evidence: TAS. Frequency: Frequent (HP:0040282). (ORPHA:3051)
- Status epilepticus (HP:0002133): Status epilepticus is a type of prolonged seizure resulting either from the failure of the mechanisms responsible for seizure termination or from the initiation of mechanisms which lead to abnormally prolonged seizures (after time point t1). It is a condition that can have long-term consequences (after time point t2), including neuronal death, neuronal injury, and alteration of neuronal networks, depending on the type and duration of seizures. Evidence: TAS. Frequency: Frequent (HP:0040282). (ORPHA:3051)
- Highly arched eyebrow (HP:0002553): Increased height of the central portion of the eyebrow, forming a crescent, semicircular, or inverted U shape. Evidence: TAS. Frequency: Frequent (HP:0040282). (ORPHA:3051)
- Scoliosis (HP:0002650): The presence of an abnormal lateral curvature of the spine. Evidence: TAS. Frequency: Frequent (HP:0040282). (ORPHA:3051)
- Severe short stature (HP:0003510): A severe degree of short stature, more than -4 SD from the mean corrected for age and sex. Evidence: TAS. Frequency: Frequent (HP:0040282). (ORPHA:3051)
- Wide intermamillary distance (HP:0006610): A larger than usual distance between the left and right nipple. Evidence: TAS. Frequency: Frequent (HP:0040282). (ORPHA:3051)
- Excessive wrinkled skin (HP:0007392). Evidence: TAS. Frequency: Frequent (HP:0040282). (ORPHA:3051)
- Curly eyelashes (HP:0007665): Abnormally curly or curved eyelashes. Evidence: TAS. Frequency: Frequent (HP:0040282). (ORPHA:3051)
- Broad distal phalanx of finger (HP:0009836): Abnormally wide (broad) distal phalanx of finger. Evidence: TAS. Frequency: Frequent (HP:0040282). (ORPHA:3051)
- Abnormal hair pattern (HP:0010720): An abnormality of the distribution of hair growth. Evidence: TAS. Frequency: Frequent (HP:0040282). (ORPHA:3051)
- Epileptic spasm (HP:0011097): A sudden flexion, extension, or mixed extension-flexion of predominantly proximal and truncal muscles that is usually more sustained than a myoclonic movement but not as sustained as a tonic seizure. Limited forms may occur: Grimacing, head nodding, or subtle eye movements. Epileptic spasms frequently occur in clusters. Infantile spasms are the best known form, but spasms can occur at all ages. Evidence: TAS. Frequency: Frequent (HP:0040282). (ORPHA:3051)
- Short palpebral fissure (HP:0012745): Distance between the medial and lateral canthi is more than 2 SD below the mean for age (objective); or, apparently reduced length of the palpebral fissures. Evidence: TAS. Frequency: Frequent (HP:0040282). (ORPHA:3051)
- Clubbing of toes (HP:0100760): Terminal broadening of the toes (distal phalanges of the toes). Evidence: TAS. Frequency: Frequent (HP:0040282). (ORPHA:3051)
- Downslanted palpebral fissures (HP:0000494): The palpebral fissure inclination is more than two standard deviations below the mean. Evidence: TAS. Frequency: Occasional (HP:0040283). (ORPHA:3051)
- Delayed skeletal maturation (HP:0002750): A decreased rate of skeletal maturation. Delayed skeletal maturation can be diagnosed on the basis of an estimation of the bone age from radiographs of specific bones in the human body. Evidence: TAS. Frequency: Occasional (HP:0040283). (ORPHA:3051)
- Accelerated skeletal maturation (HP:0005616): An abnormally increased rate of skeletal maturation. Accelerated skeletal maturation can be diagnosed on the basis of an estimation of the bone age from radiographs of specific bones in the human body. Evidence: TAS. Frequency: Occasional (HP:0040283). (ORPHA:3051)
- Abnormal epiphysis morphology (HP:0005930): An anomaly of epiphysis, which is the expanded articular end of a long bone that developes from a secondary ossification center, and which during the period of growth is either entirely cartilaginous or is separated from the shaft by a cartilaginous disk. Evidence: TAS. Frequency: Occasional (HP:0040283). (ORPHA:3051)
- Abnormal cardiovascular system morphology (HP:0030680): Any structural anomaly of the heart and blood vessels. Evidence: TAS. Frequency: Occasional (HP:0040283). (ORPHA:3051)
- Hernia (HP:0100790). Evidence: TAS. Frequency: Occasional (HP:0040283). (ORPHA:3051)
- Abnormal metacarpal morphology (HP:0005916): Any abnormal shape or structure of the metacarpal bones. Evidence: TAS. Frequency: Very frequent (HP:0040281). (ORPHA:3051)
These phenotypes are associated with the disease Nicolaides-Baraitser syndrome (ORPHA:3051).